Phenotypes associated with the disease Parotidomegaly, hereditary bilateral (OMIM:168800):
- Abnormality of the neck (HP:0000464): An abnormality of the neck. Evidence: IEA. (OMIM:168800)
- Autosomal dominant inheritance (HP:0000006): A mode of inheritance that is observed for traits related to a gene encoded on one of the autosomes (i.e., the human chromosomes 1-22) in which a trait manifests in heterozygotes. In the context of medical genetics, an autosomal dominant disorder is caused when a single copy of the mutant allele is present. Males and females are affected equally, and can both transmit the disorder with a risk of 50% for each child of inheriting the mutant allele. Evidence: IEA. (OMIM:168800)